Phenotypes associated with the disease Folinic acid-responsive seizures (ORPHA:79097):
- Gait disturbance (HP:0001288): The term gait disturbance can refer to any disruption of the ability to walk. Evidence: TAS. Frequency: Occasional (HP:0040283). (ORPHA:79097)
- Seizure (HP:0001250): A seizure is an intermittent abnormality of nervous system physiology characterized by a transient occurrence of signs and/or symptoms due to abnormal excessive or synchronous neuronal activity in the brain. Evidence: TAS. Frequency: Very frequent (HP:0040281). (ORPHA:79097)
- Ataxia (HP:0001251): Ataxia refers to impaired coordination of voluntary muscle movement. Cerebellar ataxia refers to ataxia due to dysfunction of the cerebellum. This causes a variety of elementary neurological deficits including asynergy (lack of coordination between muscles, limbs and joints), dysmetria (lack of ability to judge distances that can lead to under- or overshoot in grasping movements), and dysdiadochokinesia (inability to perform rapid movements requiring antagonizing muscle groups to be switched on and off repeatedly). Evidence: TAS. Frequency: Very frequent (HP:0040281). (ORPHA:79097)
- Global developmental delay (HP:0001263): A delay in the achievement of motor or mental milestones in the domains of development of a child, including motor skills, speech and language, cognitive skills, and social and emotional skills. This term should only be used to describe children younger than five years of age. Evidence: TAS. Frequency: Very frequent (HP:0040281). (ORPHA:79097)
- Decreased CSF 5-methyltetrahydrofolate concentration (HP:0012446): A reduced concentration of 5-methyltetrahydrofolate(2-) in the cerebrospinal fluid (CSF). 5-methyltetrahydrofolate is the active folate metabolite. Evidence: TAS. Frequency: Very frequent (HP:0040281). (ORPHA:79097)
- Atypical behavior (HP:0000708): Atypical behavior is an abnormality in a person's actions that can be controlled or modulated by the will of the individual. While abnormal behaviors can be difficult to control, they are distinct from other abnormal actions that cannot be affected by the individual's will. Evidence: TAS. Frequency: Frequent (HP:0040282). (ORPHA:79097)
- Autistic behavior (HP:0000729): Persistent deficits in social interaction and communication and interaction as well as a markedly restricted repertoire of activity and interest as well as repetitive patterns of behavior. Evidence: TAS. Frequency: Frequent (HP:0040282). (ORPHA:79097)
- Cerebellar atrophy (HP:0001272): Cerebellar atrophy is defined as a cerebellum with initially normal structures, in a posterior fossa with normal size, which displays enlarged fissures (interfolial spaces) in comparison to the foliae secondary to loss of tissue. Cerebellar atrophy implies irreversible loss of tissue and result from an ongoing progressive disease until a final stage is reached or a single injury, e.g. an intoxication or infectious event. Evidence: TAS. Frequency: Frequent (HP:0040282). (ORPHA:79097)
- Encephalopathy (HP:0001298): Encephalopathy is a term that means brain disease, damage, or malfunction. In general, encephalopathy is manifested by an altered mental state. Evidence: TAS. Frequency: Frequent (HP:0040282). (ORPHA:79097)
- Respiratory distress (HP:0002098): Respiratory distress is objectively observable as the physical or emotional consequences from the experience of dyspnea. The physical presentation of respiratory distress is generally referred to as labored breathing, while the sensation of respiratory distress is called shortness of breath or dyspnea. Evidence: TAS. Frequency: Frequent (HP:0040282). (ORPHA:79097)
- Abdominal distention (HP:0003270): Distention of the abdomen. Evidence: TAS. Frequency: Frequent (HP:0040282). (ORPHA:79097)
- Functional motor deficit (HP:0004302). Evidence: TAS. Frequency: Frequent (HP:0040282). (ORPHA:79097)
- Cerebral hypomyelination (HP:0006808): Reduced amount of myelin in the nervous system resulting from defective myelinogenesis in the white matter of the central nervous system. Evidence: TAS. Frequency: Frequent (HP:0040282). (ORPHA:79097)
- Multifocal epileptiform discharges (HP:0010841): An abnormality in cerebral electrical activity recorded along the scalp by electroencephalography (EEG) and being identified at multiple locations (foci). Evidence: TAS. Frequency: Frequent (HP:0040282). (ORPHA:79097)
- EEG with generalized slow activity (HP:0010845): Diffuse slowing of cerebral electrical activity recorded along the scalp by electroencephalography (EEG). Evidence: TAS. Frequency: Frequent (HP:0040282). (ORPHA:79097)
- Delayed myelination (HP:0012448): Delayed myelination. Evidence: TAS. Frequency: Frequent (HP:0040282). (ORPHA:79097)
- Elevated CSF neopterin level (HP:0040204): Increased concentration of neopterin in the cerebrospinal fluid (CSF). Evidence: TAS. Frequency: Frequent (HP:0040282). (ORPHA:79097)
- Sensorineural hearing impairment (HP:0000407): A type of hearing impairment in one or both ears related to an abnormal functionality of the cochlear nerve. Evidence: TAS. Frequency: Occasional (HP:0040283). (ORPHA:79097)
- Myopia (HP:0000545): An abnormality of refraction characterized by the ability to see objects nearby clearly, while objects in the distance appear blurry. Evidence: TAS. Frequency: Occasional (HP:0040283). (ORPHA:79097)
- Optic atrophy (HP:0000648): Atrophy of the optic nerve. Optic atrophy results from the death of the retinal ganglion cell axons that comprise the optic nerve and manifesting as a pale optic nerve on fundoscopy. Evidence: TAS. Frequency: Occasional (HP:0040283). (ORPHA:79097)
- Irritability (HP:0000737): An emotional state characterized by negative feelings of heightened frustration, annoyance, or feeling upset, often triggered by internal factors (e.g., fatigue, hunger, unfulfilled desires) or external factors (e.g., social or environmental challenges). Irritability may be unpredictable, and is accompanied by a lowered threshold for emotional reactivity and observable features (speech, facial expressions, or psychomotor activity). Evidence: TAS. Frequency: Occasional (HP:0040283). (ORPHA:79097)
- Hypertonia (HP:0001276): A condition in which there is increased muscle tone so that arms or legs, for example, are stiff and difficult to move. Evidence: TAS. Frequency: Occasional (HP:0040283). (ORPHA:79097)
- Spastic tetraparesis (HP:0001285): Spastic weakness affecting all four limbs. Evidence: TAS. Frequency: Occasional (HP:0040283). (ORPHA:79097)
- Dystonia (HP:0001332): An abnormally increased muscular tone that causes fixed abnormal postures. There is a slow, intermittent twisting motion that leads to exaggerated turning and posture of the extremities and trunk. Evidence: TAS. Frequency: Occasional (HP:0040283). (ORPHA:79097)
- Hyperreflexia (HP:0001347): Hyperreflexia is the presence of hyperactive stretch reflexes of the muscles. Evidence: TAS. Frequency: Occasional (HP:0040283). (ORPHA:79097)
- Chorea (HP:0002072): Chorea (Greek for 'dance') refers to widespread arrhythmic involuntary movements of a forcible, jerky and restless fashion. It is a random-appearing sequence of one or more discrete involuntary movements or movement fragments. Movements appear random because of variability in timing, duration or location. Each movement may have a distinct start and end. However, movements may be strung together and thus may appear to flow randomly from one muscle group to another. Chorea can involve the trunk, neck, face, tongue, and extremities. Evidence: TAS. Frequency: Occasional (HP:0040283). (ORPHA:79097)
- Apnea (HP:0002104): Lack of breathing with no movement of the respiratory muscles and no exchange of air in the lungs. This term refers to a disposition to have recurrent episodes of apnea rather than to a single event. Evidence: TAS. Frequency: Occasional (HP:0040283). (ORPHA:79097)
- Generalized myoclonic seizure (HP:0002123): A generalized myoclonic seizure is a type of generalized motor seizure characterized by bilateral, sudden, brief (<100 ms) involuntary single or multiple contraction of muscles or muscle groups of variable topography (axial, proximal limb, distal). Myoclonus is less regularly repetitive and less sustained than is clonus. Evidence: TAS. Frequency: Occasional (HP:0040283). (ORPHA:79097)
- Status epilepticus (HP:0002133): Status epilepticus is a type of prolonged seizure resulting either from the failure of the mechanisms responsible for seizure termination or from the initiation of mechanisms which lead to abnormally prolonged seizures (after time point t1). It is a condition that can have long-term consequences (after time point t2), including neuronal death, neuronal injury, and alteration of neuronal networks, depending on the type and duration of seizures. Evidence: TAS. Frequency: Occasional (HP:0040283). (ORPHA:79097)
- Broad-based gait (HP:0002136): An abnormal gait pattern in which persons stand and walk with their feet spaced widely apart. This is often a component of cerebellar ataxia. Evidence: TAS. Frequency: Occasional (HP:0040283). (ORPHA:79097)
- Sleep disturbance (HP:0002360): An abnormal pattern in the quality, quantity, or characteristics of sleep. Evidence: TAS. Frequency: Occasional (HP:0040283). (ORPHA:79097)
- Developmental regression (HP:0002376): Loss of developmental skills, as manifested by loss of developmental milestones. Evidence: TAS. Frequency: Occasional (HP:0040283). (ORPHA:79097)
- Poor speech (HP:0002465). Evidence: TAS. Frequency: Occasional (HP:0040283). (ORPHA:79097)
- Hypsarrhythmia (HP:0002521): Hypsarrhythmia is abnormal interictal high amplitude waves and a background of irregular spikes. There is continuous (during wakefulness), high-amplitude (>200 Hz), generalized polymorphic slowing with no organized background and multifocal spikes demonstrated by electroencephalography (EEG). Evidence: TAS. Frequency: Occasional (HP:0040283). (ORPHA:79097)
- Frontotemporal cerebral atrophy (HP:0006892): Atrophy (wasting, decrease in size of cells or tissue) affecting the frontotemporal cerebrum. Evidence: TAS. Frequency: Occasional (HP:0040283). (ORPHA:79097)
- Atonic seizure (HP:0010819): Atonic seizure is a type of motor seizure characterized by a sudden loss or diminution of muscle tone without apparent preceding myoclonic or tonic event lasting about 1 to 2 seconds, involving head, trunk, jaw, or limb musculature. Evidence: TAS. Frequency: Occasional (HP:0040283). (ORPHA:79097)
- Clonic seizure (HP:0020221): A clonic seizure is a type of motor seizure characterized by sustained rhythmic jerking, that is regularly repetitive. Evidence: TAS. Frequency: Occasional (HP:0040283). (ORPHA:79097)
- Abnormality of movement (HP:0100022): An abnormality of movement with a neurological basis characterized by changes in coordination and speed of voluntary movements. Evidence: TAS. Frequency: Occasional (HP:0040283). (ORPHA:79097)